Phenotypes associated with the disease Trichodermodysplasia-dental alterations syndrome (ORPHA:3353):
- Abnormal morphology of female internal genitalia (HP:0000008): An abnormality of the female internal genitalia. Evidence: TAS. Frequency: Occasional (HP:0040283). (ORPHA:3353)
- Delayed eruption of teeth (HP:0000684): Delayed tooth eruption, which can be defined as tooth eruption more than 2 SD beyond the mean eruption age. Evidence: TAS. Frequency: Frequent (HP:0040282). (ORPHA:3353)
- Palmoplantar keratoderma (HP:0000982): Abnormal thickening of the skin of the palms of the hands and the soles of the feet. Evidence: TAS. Frequency: Frequent (HP:0040282). (ORPHA:3353)
- Sparse scalp hair (HP:0002209): Decreased number of hairs per unit area of skin of the scalp. Evidence: TAS. Frequency: Very frequent (HP:0040281). (ORPHA:3353)
- Fine hair (HP:0002213): Hair that is fine or thin to the touch. Evidence: TAS. Frequency: Very frequent (HP:0040281). (ORPHA:3353)
- Brittle hair (HP:0002299): Fragile, easily breakable hair, i.e., with reduced tensile strength. Evidence: TAS. Frequency: Very frequent (HP:0040281). (ORPHA:3353)
- Scoliosis (HP:0002650): The presence of an abnormal lateral curvature of the spine. Evidence: TAS. Frequency: Frequent (HP:0040282). (ORPHA:3353)
- Abnormal hip bone morphology (HP:0003272): An abnormality of the hip bone. Evidence: TAS. Frequency: Occasional (HP:0040283). (ORPHA:3353)
- Hyperlordosis (HP:0003307): Abnormally increased curvature (anterior concavity) of the lumbar or cervical spine. Evidence: TAS. Frequency: Frequent (HP:0040282). (ORPHA:3353)
- Sparse lateral eyebrow (HP:0005338): Decreased density/number and/or decreased diameter of lateral eyebrow hairs. Evidence: TAS. Frequency: Frequent (HP:0040282). (ORPHA:3353)
- Abnormal dental morphology (HP:0006482): An abnormality of the morphology of the tooth. Evidence: TAS. Frequency: Very frequent (HP:0040281). (ORPHA:3353)
- Multiple cafe-au-lait spots (HP:0007565): The presence of six or more cafe-au-lait spots. Evidence: TAS. Frequency: Occasional (HP:0040283). (ORPHA:3353)
- Neoplasm of the skin (HP:0008069): A tumor (abnormal growth of tissue) of the skin. Evidence: TAS. Frequency: Very frequent (HP:0040281). (ORPHA:3353)
- High hypermetropia (HP:0008499): A severe form of hypermetropia with over +5.00 diopters. Evidence: TAS. Frequency: Occasional (HP:0040283). (ORPHA:3353)
- Supernumerary tooth (HP:0011069): The presence of one or more teeth additional to the normal number. Evidence: TAS. Frequency: Frequent (HP:0040282). (ORPHA:3353)
- Aplasia/Hypoplasia of the eyebrow (HP:0100840): Absence or underdevelopment of the eyebrow. Evidence: TAS. Frequency: Very frequent (HP:0040281). (ORPHA:3353)
- Adenoma sebaceum (HP:0009720): The presence of a sebaceous adenoma with origin in the sebum secreting cells of the skin. Evidence: TAS. Frequency: Occasional (HP:0040283). (ORPHA:3353)
- Tooth agenesis (HP:0009804): The absence of one or more teeth from the normal series by a failure to develop. Evidence: TAS. Frequency: Very frequent (HP:0040281). (ORPHA:3353)
- Sparse or absent eyelashes (HP:0200102). Evidence: TAS. Frequency: Very frequent (HP:0040281). (ORPHA:3353)